- Juvenile onset (HP:0003621): Onset of signs or symptoms of disease between the age of 5 and 15 years. Evidence: PCS. Frequency: 3/3. (PMID:31175426)
- Sensorineural hearing impairment (HP:0000407): A type of hearing impairment in one or both ears related to an abnormal functionality of the cochlear nerve. Evidence: PCS. Frequency: 3/3. (PMID:31175426)
- Global developmental delay (HP:0001263): A delay in the achievement of motor or mental milestones in the domains of development of a child, including motor skills, speech and language, cognitive skills, and social and emotional skills. This term should only be used to describe children younger than five years of age. Evidence: PCS. Frequency: 0/3. (PMID:31175426)
- Autosomal recessive inheritance (HP:0000007): A mode of inheritance that is observed for traits related to a gene encoded on one of the autosomes (i.e., the human chromosomes 1-22) in which a trait manifests in individuals with two pathogenic alleles, either homozygotes (two copies of the same mutant allele) or compound heterozygotes (whereby each copy of a gene has a distinct mutant allele). Evidence: PCS. (PMID:31175426)
- Positive Romberg sign (HP:0002403): The patient stands with the feet placed together and balance and is asked to close his or her eyes. A loss of balance upon eye closure is a positive Romberg sign and is interpreted as indicating a deficit in proprioception. Evidence: PCS. Frequency: 0/3. (PMID:31175426)
These phenotypes are associated with the disease hearing loss, autosomal recessive 116 (OMIM:619093).